Phenotypes associated with the disease hernia, anterior diaphragmatic (OMIM:306950):
- Neonatal death (HP:0003811): Death within the first 28 days of life. Evidence: TAS. (OMIM:306950)
- Congenital diaphragmatic hernia (HP:0000776): The presence of a hernia of the diaphragm present at birth. Evidence: TAS. (OMIM:306950)